- Pruritus (HP:0000989): Pruritus is an itch or a sensation that makes a person want to scratch. This term refers to an abnormally increased disposition to experience pruritus. Evidence: TAS. Frequency: Frequent (HP:0040282). (ORPHA:33314)
- Cutaneous photosensitivity (HP:0000992): An increased sensitivity of the skin to light. Photosensitivity may result in a rash upon exposure to the sun (which is known as photodermatosis). Photosensitivity can be diagnosed by phototests in which light is shone on small areas of skin. Evidence: TAS. Frequency: Frequent (HP:0040282). (ORPHA:33314)
- Abnormal lymphocyte morphology (HP:0004332): An abnormality of lymphocytes. Evidence: TAS. Frequency: Frequent (HP:0040282). (ORPHA:33314)
- Erythema (HP:0010783): Redness of the skin, caused by hyperemia of the capillaries in the lower layers of the skin. Evidence: TAS. Frequency: Very frequent (HP:0040281). (ORPHA:33314)
- Papule (HP:0200034): A circumscribed, solid elevation of skin with no visible fluid, varying in size from a pinhead to less than 10mm in diameter at the widest point. Evidence: TAS. Frequency: Very frequent (HP:0040281). (ORPHA:33314)
- Skin plaque (HP:0200035): A plaque is a solid, raised, plateau-like (flat-topped) lesion greater than 1 cm in diameter. Evidence: TAS. Frequency: Very frequent (HP:0040281). (ORPHA:33314)
These phenotypes are associated with the disease Jessner lymphocytic infiltration of the skin (ORPHA:33314).